Phenotypes associated with the disease microcephaly 23, primary, autosomal recessive (OMIM:617985):
- Sloping forehead (HP:0000340): Inclination of the anterior surface of the forehead from the vertical more than two standard deviations above the mean (objective); or apparently excessive posterior sloping of the forehead in a lateral view. Evidence: PCS. Frequency: 1/1. (PMID:27737959)
- Microcephaly (HP:0000252): Head circumference below 2 standard deviations below the mean for age and gender. Evidence: PCS. Frequency: 1/1. (PMID:27737959)
- Congenital onset (HP:0003577): A phenotypic abnormality that is present at birth. Evidence: PCS. Frequency: 1/1. (PMID:27737959)
- Moderate intellectual disability (HP:0002342): Moderate intellectual disability (ID) is defined as a type of ID characterized by moderately sub-average adaptive functioning and intellectual functioning, with an intelligence quotient (IQ) the range of 35-49. Evidence: PCS. Frequency: 1/1. (PMID:27737959)
- Small for gestational age (HP:0001518): Smaller than normal size according to sex and gestational age related norms, defined as a weight below the 10th percentile for the gestational age. Evidence: PCS. Frequency: 1/1. (PMID:27737959)
- Autosomal recessive inheritance (HP:0000007): A mode of inheritance that is observed for traits related to a gene encoded on one of the autosomes (i.e., the human chromosomes 1-22) in which a trait manifests in individuals with two pathogenic alleles, either homozygotes (two copies of the same mutant allele) or compound heterozygotes (whereby each copy of a gene has a distinct mutant allele). Evidence: PCS. (PMID:27737959)